- Anhidrotic ectodermal dysplasia (HP:0007476). Evidence: TAS. (OMIM:125050)
- Progressive hearing impairment (HP:0001730): A progressive form of hearing impairment. Evidence: TAS. (OMIM:125050)
- Autosomal dominant inheritance (HP:0000006): A mode of inheritance that is observed for traits related to a gene encoded on one of the autosomes (i.e., the human chromosomes 1-22) in which a trait manifests in heterozygotes. In the context of medical genetics, an autosomal dominant disorder is caused when a single copy of the mutant allele is present. Males and females are affected equally, and can both transmit the disorder with a risk of 50% for each child of inheriting the mutant allele. Evidence: TAS. (OMIM:125050)
These phenotypes are associated with the disease deafness with anhidrotic ectodermal dysplasia (OMIM:125050).